- Ectopic kidney (HP:0000086): A developmental defect in which a kidney is located in an abnormal anatomic position. Evidence: IEA. (OMIM:169545)
- Pelvic lipomatosis (HP:0034009): Overgrowth of fat in the perivesical and perirectal area. Evidence: TAS. (OMIM:169545)
- Autosomal dominant inheritance (HP:0000006): A mode of inheritance that is observed for traits related to a gene encoded on one of the autosomes (i.e., the human chromosomes 1-22) in which a trait manifests in heterozygotes. In the context of medical genetics, an autosomal dominant disorder is caused when a single copy of the mutant allele is present. Males and females are affected equally, and can both transmit the disorder with a risk of 50% for each child of inheriting the mutant allele. Evidence: IEA. (OMIM:169545)
These phenotypes are associated with the disease pelvic lipomatosis with crossed renal ectopia (OMIM:169545).